- Irregular astigmatism (HP:0031792): A type of astigmatism in which the principle meridians are not 90 degrees apart and which is associated with loss of vision. Evidence: TAS. Frequency: Occasional (HP:0040283). (ORPHA:293603)
- Blurred vision (HP:0000622): Lack of sharpness of vision resulting in the inability to see fine detail. Evidence: TAS. Frequency: Frequent (HP:0040282). (ORPHA:293603)
- Nystagmus (HP:0000639): Rhythmic, involuntary oscillations of one or both eyes related to abnormality in fixation, conjugate gaze, or vestibular mechanisms. Evidence: TAS. Frequency: Occasional (HP:0040283). (ORPHA:293603)
- Increased corneal thickness (HP:0011487): A increased anteroposterior thickness of the cornea. Evidence: TAS. Frequency: Very frequent (HP:0040281). (ORPHA:293603)
- Corneal opacity (HP:0007957): A reduction of corneal clarity. Evidence: TAS. Frequency: Very frequent (HP:0040281). (ORPHA:293603)
- Abnormal Descemet membrane morphology (HP:0011490): Abnormality of Descemet's membrane, which is the basement membrane of the corneal endothelium. Evidence: TAS. Frequency: Very frequent (HP:0040281). (ORPHA:293603)
- Corneal stromal edema (HP:0012040): Abnormal accumulation of fluid and swelling of the stroma of cornea. Evidence: TAS. Frequency: Very frequent (HP:0040281). (ORPHA:293603)
- Reduced visual acuity (HP:0007663). Evidence: TAS. Frequency: Frequent (HP:0040282). (ORPHA:293603)
- Sensorineural hearing impairment (HP:0000407): A type of hearing impairment in one or both ears related to an abnormal functionality of the cochlear nerve. Evidence: TAS. Frequency: Occasional (HP:0040283). (ORPHA:293603)
These phenotypes are associated with the disease Congenital hereditary endothelial dystrophy type II (ORPHA:293603).